Phenotypes associated with the disease cerebral angiopathy, dysphoric (OMIM:213500):
- Abnormality of the nervous system (HP:0000707): An abnormality of the nervous system. Evidence: IEA. (OMIM:213500)
- Autosomal recessive inheritance (HP:0000007): A mode of inheritance that is observed for traits related to a gene encoded on one of the autosomes (i.e., the human chromosomes 1-22) in which a trait manifests in individuals with two pathogenic alleles, either homozygotes (two copies of the same mutant allele) or compound heterozygotes (whereby each copy of a gene has a distinct mutant allele). Evidence: IEA. (OMIM:213500)